Phenotypes associated with the disease photoparoxysmal response 1 (OMIM:132100):
- EEG with photoparoxysmal response (HP:0010852): EEG abnormalities (epileptiform discharges) evoked by flashing lights or black and white striped patterns. Evidence: TAS. (OMIM:132100)
- Typified by age-related disease onset (HP:0003831): Description of conditions in which age of onset is typically later in life and in which penetrance is dependent on the age of the subject. Evidence: TAS. (OMIM:132100)
- Autosomal dominant inheritance (HP:0000006): A mode of inheritance that is observed for traits related to a gene encoded on one of the autosomes (i.e., the human chromosomes 1-22) in which a trait manifests in heterozygotes. In the context of medical genetics, an autosomal dominant disorder is caused when a single copy of the mutant allele is present. Males and females are affected equally, and can both transmit the disorder with a risk of 50% for each child of inheriting the mutant allele. Evidence: TAS. (OMIM:132100)